Phenotypes associated with the disease pilonidal sinus (OMIM:173000, an entry in Online Mendelian Inheritance in Man):
- Pilonidal sinus (HP:0010769, a Human Phenotype Ontology term): A sinus in the coccygeal region (the region of the intergluteal cleft). A pilonidal sinus often contains hair and skin debris. Evidence: IEA. (OMIM:173000)
- Autosomal dominant inheritance (HP:0000006, a Human Phenotype Ontology term): A mode of inheritance that is observed for traits related to a gene encoded on one of the autosomes (i.e., the human chromosomes 1-22) in which a trait manifests in heterozygotes. In the context of medical genetics, an autosomal dominant disorder is caused when a single copy of the mutant allele is present. Males and females are affected equally, and can both transmit the disorder with a risk of 50% for each child of inheriting the mutant allele. Evidence: IEA. (OMIM:173000)